- Bifid scrotum (HP:0000048): Midline indentation or cleft of the scrotum. Evidence: TAS. Frequency: Frequent (HP:0040282). (ORPHA:1547)
- Telecanthus (HP:0000506): Distance between the inner canthi more than two standard deviations above the mean (objective); or, apparently increased distance between the inner canthi. Evidence: TAS. Frequency: Frequent (HP:0040282). (ORPHA:1547)
- Freckling (HP:0001480): The presence of an increased number of freckles, small circular spots on the skin that are darker than the surrounding skin because of deposits of melanin. Evidence: TAS. Frequency: Frequent (HP:0040282). (ORPHA:1547)
- Hypoplastic toenails (HP:0001800): Underdevelopment of the toenail. Evidence: TAS. Frequency: Frequent (HP:0040282). (ORPHA:1547)
- Brachytelomesophalangy (HP:0005872): Disproportionately short middle and distal phalanges compared to the hand/foot. Evidence: TAS. Frequency: Very frequent (HP:0040281). (ORPHA:1547)
- Abnormal dermatoglyphics (HP:0007477): An abnormality of dermatoglyphs (fingerprints), which are present on fingers, palms, toes, and soles. Evidence: TAS. Frequency: Very frequent (HP:0040281). (ORPHA:1547)
- Short distal phalanx of finger (HP:0009882): Short distance from the end of the finger to the most distal interphalangeal crease or the distal interphalangeal joint flexion point. That is, hypoplasia of one or more of the distal phalanx of finger. Evidence: TAS. Frequency: Very frequent (HP:0040281). (ORPHA:1547)
These phenotypes are associated with the disease Cryptomicrotia-brachydactyly-excess fingertip arch syndrome (ORPHA:1547).